- Abnormal respiratory system physiology (HP:0002795): Abnormal function of the respiratory system. Evidence: TAS. (OMIM:242670)
- Chronic rhinitis (HP:0002257): Chronic inflammation of the nasal mucosa. Evidence: TAS. (OMIM:242670)
- Ciliary dyskinesia (HP:0012265): A deviation from the normally well coordinated pattern of intracellular and intercellular synchrony of motile cilia. Dyskinetic cilia usually beat out of synchrony relative to neighboring cilia. Evidence: IEA. (OMIM:242670)
- Absent respiratory ciliary axoneme radial spokes (HP:0012267): Absence of the radial spokes of the axoneme of the respiratory cilium. Evidence: TAS. (OMIM:242670)
- Immotile cilia (HP:0012263). Evidence: TAS. (OMIM:242670)
- Autosomal recessive inheritance (HP:0000007): A mode of inheritance that is observed for traits related to a gene encoded on one of the autosomes (i.e., the human chromosomes 1-22) in which a trait manifests in individuals with two pathogenic alleles, either homozygotes (two copies of the same mutant allele) or compound heterozygotes (whereby each copy of a gene has a distinct mutant allele). Evidence: TAS. (OMIM:242670)
- Nasal polyposis (HP:0100582): Polypoidal masses arising mainly from the mucous membranes of the nose and paranasal sinuses. They are freely movable and nontender overgrowths of the mucosa that frequently accompany allergic rhinitis. Evidence: TAS. (OMIM:242670)
- Immotile sperm (HP:0012208): A lack of mobility of ejaculated sperm. Evidence: TAS. (OMIM:242670)
- Sinusitis (HP:0000246): Inflammation of the paranasal sinuses owing to a viral, bacterial, or fungal infection, allergy, or an autoimmune reaction. Evidence: TAS. (OMIM:242670)
These phenotypes are associated with the disease ciliary dyskinesia with defective radial spokes (OMIM:242670).